- Juvenile onset (HP:0003621): Onset of signs or symptoms of disease between the age of 5 and 15 years. Evidence: PCS. Frequency: 3/3. (PMID:34214472)
- Persistent EBV viremia (HP:0020072): Persistent or recurrent detection of Epstein-Barr virus (EBV) in the blood that occurs in the context of unusual susceptibility to infection. Evidence: PCS. Frequency: 3/3. (PMID:34214472)
- Unusual molluscum contagiosum (HP:0032163): Molluscum contagiosum is a cutaneous viral infection that is commonly observed in both healthy and immunocompromised children. The infection is caused by a member of the Poxviridae family, the molluscum contagiosum virus. Molluscum contagiosum presents as single or multiple small white or flesh-colored papules that typically have a central umbilication. The central umbilication may be difficult to observe in young children and, instead, may bear an appearance similar to an acneiform eruption. The lesions vary in size (from 1 mm to 1 cm in diameter) and are painless, although a subset of patients report pruritus in the area of infection. On average, 11-20 papules appear on the body during the course of infection and generally remains a self-limiting disease. However, in immunosuppressed patients, molluscum contagiosum can be a severe infection with hundreds of lesions developing on the body. Extensive eruption is indicative of an advanced immunodeficiency state. Evidence: PCS. Frequency: 0/3. (PMID:34214472)
- Cutaneous horn (HP:0033510): A cutaneous horn is a keratinized non-malignant protrusion on the surface of the skin. Diagnosis is established by biopsy of the horn and biopsy of the horn and the underlying skin. Evidence: PCS. Frequency: 1/3. (PMID:34214472)
- Recurrent otitis media (HP:0000403): Increased susceptibility to otitis media, as manifested by recurrent episodes of otitis media. Evidence: PCS. Frequency: 1/3. (PMID:34214472)
- Autosomal recessive inheritance (HP:0000007): A mode of inheritance that is observed for traits related to a gene encoded on one of the autosomes (i.e., the human chromosomes 1-22) in which a trait manifests in individuals with two pathogenic alleles, either homozygotes (two copies of the same mutant allele) or compound heterozygotes (whereby each copy of a gene has a distinct mutant allele). Evidence: PCS. (PMID:34214472)
- Genital warts (HP:0032301): Warts affecting the skin in the genital area (penile shaft, scrotum, vagina, or labia majora). Warts can be small, beginning as a pinhead-size swelling that may become larger and take on a pedunculated appearance. Warts can spread and coalesce into large masses in the genital or anal area. Their color is variable but tends to be skin colored or darker, and they may occasionally bleed. Warts may cause itching, redness, or discomfort. An outbreak of genital warts may also cause psychological distress. Evidence: PCS. Frequency: 0/3. (PMID:34214472)
- Persistent CMV viremia (HP:0032247): Persistent or recurrent detection of cytomegalovirus (CMV) in the blood that occurs in the context of unusual susceptibility to infection. Evidence: PCS. Frequency: 2/2. (PMID:34214472)
- Disseminated cutaneous warts (HP:0032215): Multiple skin warts located in multiple parts of the body, e.g., neck, trunks, and extremities. Evidence: PCS. Frequency: 1/3. (PMID:34214472)
- Verruca plana (HP:0550004): Slightly raised wart 2-5 mm in diameter often associated with viral infections, commonly persistent in immunodeficient individuals. Evidence: PCS. Frequency: 0/3. (PMID:34214472)
- Verrucae (HP:0200043): Warts, benign growths on the skin or mucous membranes that cause cosmetic problems as well as pain and discomfort. Warts most often occur on the hands, feet, and genital areas. Evidence: PCS. Frequency: 2/2. (PMID:34214472)
These phenotypes are associated with the disease immunodeficiency 123 with HPV-related verrucosis (OMIM:620901).